- Abnormality of metabolism/homeostasis (HP:0001939). Evidence: IEA. (OMIM:168820)
- Autosomal dominant inheritance (HP:0000006): A mode of inheritance that is observed for traits related to a gene encoded on one of the autosomes (i.e., the human chromosomes 1-22) in which a trait manifests in heterozygotes. In the context of medical genetics, an autosomal dominant disorder is caused when a single copy of the mutant allele is present. Males and females are affected equally, and can both transmit the disorder with a risk of 50% for each child of inheriting the mutant allele. Evidence: IEA. (OMIM:168820)
These phenotypes are associated with the disease Paraoxonase 1 (OMIM:168820).